- Long philtrum (HP:0000343): Distance between nasal base and midline upper lip vermilion border more than 2 SD above the mean. Alternatively, an apparently increased distance between nasal base and midline upper lip vermilion border. Evidence: PCS. Frequency: 1/7. (PMID:34102099)
- Strabismus (HP:0000486): A misalignment of the eyes so that the visual axes deviate from bifoveal fixation. The classification of strabismus may be based on a number of features including the relative position of the eyes, whether the deviation is latent or manifest, intermittent or constant, concomitant or otherwise and according to the age of onset and the relevance of any associated refractive error. Evidence: PCS. Frequency: 1/6. (PMID:34102099)
- Seizure (HP:0001250): A seizure is an intermittent abnormality of nervous system physiology characterized by a transient occurrence of signs and/or symptoms due to abnormal excessive or synchronous neuronal activity in the brain. Evidence: PCS. Frequency: 3/7. (PMID:34102099)
- Turricephaly (HP:0000262): Tall head relative to width and length. Evidence: PCS. Frequency: 1/7. (PMID:34102099)
- Hypotonia (HP:0001252): Hypotonia is an abnormally low muscle tone (the amount of tension or resistance to movement in a muscle). Even when relaxed, muscles have a continuous and passive partial contraction which provides some resistance to passive stretching. Hypotonia thus manifests as diminished resistance to passive stretching. Hypotonia is not the same as muscle weakness, although the two conditions can co-exist. Evidence: PCS. Frequency: 6/7. (PMID:34102099)
- Anisometropia (HP:0012803): Inequality of refractive power of the two eyes. Evidence: PCS. Frequency: 1/6. (PMID:34102099)
- Short finger (HP:0009381): Abnormally short finger associated with developmental hypoplasia. Evidence: PCS. Frequency: 1/7. (PMID:34102099)
- Depression (HP:0000716): Frequently experiencing feelings of being down, miserable, and/or hopeless; struggling to recover from these moods; having a pessimistic outlook on the future; feeling a pervasive sense of shame; having a low self-worth; experiencing thoughts of suicide and engaging in suicidal behavior. Evidence: PCS. Frequency: 1/8. (PMID:34102099)
- Prominent forehead (HP:0011220): Forward prominence of the entire forehead, due to protrusion of the frontal bone. Evidence: PCS. Frequency: 1/7. (PMID:34102099)
- Aggressive behavior (HP:0000718): Behavior or an act aimed at harming a person, animal, or physical property (e.g., acts of physical violence; shouting, swearing, and using harsh language; slashing someone's tires). Evidence: PCS. Frequency: 4/8. (PMID:34102099)
- Anxiety (HP:0000739): Intense feelings of nervousness, tension, or panic often arise in response to interpersonal stresses. There is worry about the negative effects of past unpleasant experiences and future negative possibilities. Individuals may feel fearful, apprehensive, or threatened by uncertainty, and they may also have fears of falling apart or losing control. Evidence: PCS. Frequency: 1/8. (PMID:34102099)
- Lumbar hyperlordosis (HP:0002938): An abnormal accentuation of the inward curvature of the spine in the lumbar region. Evidence: PCS. Frequency: 1/6. (PMID:34102099)
- Hyperactivity (HP:0000752): Hyperactivity is a condition characterized by constant and unusually high levels of activity, even in situations where it is deemed inappropriate. Evidence: PCS. Frequency: 3/8. (PMID:34102099)
- Pes planus (HP:0001763): A foot where the longitudinal arch of the foot is in contact with the ground or floor when the individual is standing; or, in a patient lying supine, a foot where the arch is in contact with the surface of a flat board pressed against the sole of the foot by the examiner with a pressure similar to that expected from weight bearing; or, the height of the arch is reduced. Evidence: PCS. Frequency: 1/7. (PMID:34102099)
- Intellectual disability (HP:0001249): The term intellectual disability or intellectual developmental disorder is used to describe significantly sub-average intellectual and adaptive functioning based on clinical assessment and as measured by individually administered, appropriately normed, standardized and validated tests of intellectual functioning and adaptive behavior, with onset during the developmental period from infancy through adolescence. Evidence: PCS. Frequency: 8/8. (PMID:34102099)
- Hooded eyelid (HP:0030820): Eyelid partly covered by skin when eyes are open. Evidence: PCS. Frequency: 1/7. (PMID:34102099)
- Delayed speech and language development (HP:0000750): A degree of language development that is significantly below the norm for a child of a specified age. Evidence: PCS. Frequency: 8/8. (PMID:34102099)
- Global developmental delay (HP:0001263): A delay in the achievement of motor or mental milestones in the domains of development of a child, including motor skills, speech and language, cognitive skills, and social and emotional skills. This term should only be used to describe children younger than five years of age. Evidence: PCS. Frequency: 8/8. (PMID:34102099)
- 2-3 toe syndactyly (HP:0004691): Syndactyly with fusion of toes two and three. Evidence: PCS. Frequency: 1/7. (PMID:34102099)
- Autistic behavior (HP:0000729): Persistent deficits in social interaction and communication and interaction as well as a markedly restricted repertoire of activity and interest as well as repetitive patterns of behavior. Evidence: PCS. Frequency: 3/8. (PMID:34102099)
- Amblyopia (HP:0000646): Reduced visual acuity that is uncorrectable by lenses in the absence of detectable anatomic defects in the eye or visual pathways. Evidence: PCS. Frequency: 1/6. (PMID:34102099)
- Compulsive behaviors (HP:0000722): Behavior that consists of repetitive acts, characterized by the feeling that one "has to" perform them, while being aware that these acts are not in line with one's overall goal. Evidence: PCS. Frequency: 1/8. (PMID:34102099)
- Self-injurious behavior (HP:0100716): Self-aggression. Evidence: PCS. Frequency: 1/8. (PMID:34102099)
- Pectus carinatum (HP:0000768): A deformity of the chest caused by overgrowth of the ribs and characterized by protrusion of the sternum. Evidence: PCS. Frequency: 1/7. (PMID:34102099)
- Clinodactyly of the 5th finger (HP:0004209): Clinodactyly refers to a bending or curvature of the fifth finger in the radial direction (i.e., towards the 4th finger). Evidence: PCS. Frequency: 1/7. (PMID:34102099)
- Frontal bossing (HP:0002007): Bilateral bulging of the lateral frontal bone prominences with relative sparing of the midline. Evidence: PCS. Frequency: 1/7. (PMID:34102099)
- Esotropia (HP:0000565): A form of strabismus with one or both eyes turned inward ('crossed') to a relatively severe degree, usually defined as 10 diopters or more. Evidence: PCS. Frequency: 1/6. (PMID:34102099)
- Thoracic kyphosis (HP:0002942): Over curvature of the thoracic region, leading to a round back or if sever to a hump. Evidence: PCS. Frequency: 1/6. (PMID:34102099)
- Spasticity (HP:0001257): A motor disorder characterized by a velocity-dependent increase in tonic stretch reflexes with increased muscle tone, exaggerated (hyperexcitable) tendon reflexes. Evidence: PCS. Frequency: 1/7. (PMID:34102099)
- Autosomal dominant inheritance (HP:0000006): A mode of inheritance that is observed for traits related to a gene encoded on one of the autosomes (i.e., the human chromosomes 1-22) in which a trait manifests in heterozygotes. In the context of medical genetics, an autosomal dominant disorder is caused when a single copy of the mutant allele is present. Males and females are affected equally, and can both transmit the disorder with a risk of 50% for each child of inheriting the mutant allele. Evidence: PCS. (PMID:34102099)
These phenotypes are associated with the disease Usmani-Riazuddin syndrome, autosomal dominant (OMIM:619467).